- Ureterocele (HP:0000070): A ureterocele is a congenital saccular dilatation of the distal segment of the ureter. Evidence: IEA. (OMIM:191650)
- Duplicated collecting system (HP:0000081): A duplication of the collecting system of the kidney, defined as a kidney with two (instead of, normally, one) pyelocaliceal systems. The pyelocaliceal system is comprised of the renal pelvis and calices. The duplicated renal collecting system can be associated with a single ureter or with double ureters. In the latter case, the two ureters empty separately into the bladder or fuse to form a single ureteral orifice. Evidence: IEA. (OMIM:191650)
- Autosomal dominant inheritance (HP:0000006): A mode of inheritance that is observed for traits related to a gene encoded on one of the autosomes (i.e., the human chromosomes 1-22) in which a trait manifests in heterozygotes. In the context of medical genetics, an autosomal dominant disorder is caused when a single copy of the mutant allele is present. Males and females are affected equally, and can both transmit the disorder with a risk of 50% for each child of inheriting the mutant allele. Evidence: IEA. (OMIM:191650)
These phenotypes are associated with the disease ureterocele (OMIM:191650).